- Cleft palate (HP:0000175): Cleft palate is a developmental defect of the palate resulting from a failure of fusion of the palatine processes and manifesting as a separation of the roof of the mouth (soft and hard palate). Evidence: PCS. (PMID:19249007)
- Cleft lip (HP:0410030): A gap in the lip or lips. Evidence: PCS. (PMID:19249007)
- Polygenic inheritance (HP:0010982): A mode of inheritance that depends on a mixture of major and minor genetic determinants possibly together with environmental factors. Diseases inherited in this manner are termed complex diseases. Evidence: PCS. (PMID:19249007)
These phenotypes are associated with the disease orofacial cleft 11 (OMIM:600625).